- Ovarian thecoma (HP:0030983): A sex cord-stromal tumor of the ovary. Thecomas range from small tumors to large solid or solid-cystic masses of up to 15 cm. They are unilateral in over 90 percent of cases and are rarely malignant. Thecomas are stromal tumors made up of cells that resemble theca cells, lutein cells and fibroblasts. They are traditionally classified within the sex cord-stromal tumor category of ovarian tumor types. Evidence: PCS. (PMID:21882293)
- Pleuropulmonary blastoma (HP:0100528): A rare cancer originating in the lung or pleural cavity that occurs most often in infants and young children but also has been reported in adults. Pleuropulmonary blastoma is regarded as malignant. Evidence: PCS. (PMID:21882293)
- Thyroid nodule (HP:0025388): A nodular lesion that develops in the thyroid gland. The term "thyroid nodule" refers to any abnormal growth that forms a lump in the thyroid gland. Evidence: PCS. Onset: Juvenile onset (HP:0003621). (PMID:21882293)
- Nephroblastoma (HP:0002667): The presence of a nephroblastoma, which is a neoplasm of the kidney that primarily affects children. Evidence: PCS. Onset: Childhood onset (HP:0011463). (PMID:21882293)
- Embryonal rhabdomyosarcoma (HP:0006743). Evidence: PCS. (PMID:21882293)
- Goiter (HP:0000853): An enlargement of the thyroid gland. Evidence: PCS. Onset: Juvenile onset (HP:0003621). (PMID:21882293)
- Multinodular goiter (HP:0005987): Enlargement of the thyroid gland related to multiple nodules in the thyroid gland. Evidence: PCS. Onset: Juvenile onset (HP:0003621). (PMID:21882293)
These phenotypes are associated with the disease rhabdomyosarcoma, embryonal, 2 (OMIM:180295).